Phenotypes associated with the disease type 1 diabetes mellitus 2 (OMIM:125852):
- Early young adult onset (HP:0025708): Onset of disease at an age of greater than or equal to 16 to under 19 years. Evidence: PCS. Frequency: 2/2. (PMID:18192540)
- Type I diabetes mellitus (HP:0100651): A chronic condition in which the pancreas produces little or no insulin. Type I diabetes mellitus is manifested by the sudden onset of severe hyperglycemia with rapid progression to diabetic ketoacidosis unless treated with insulin. Evidence: PCS. Frequency: 2/2. (PMID:18192540)
- Autosomal dominant inheritance (HP:0000006): A mode of inheritance that is observed for traits related to a gene encoded on one of the autosomes (i.e., the human chromosomes 1-22) in which a trait manifests in heterozygotes. In the context of medical genetics, an autosomal dominant disorder is caused when a single copy of the mutant allele is present. Males and females are affected equally, and can both transmit the disorder with a risk of 50% for each child of inheriting the mutant allele. Evidence: PCS. (PMID:18192540)